- Typified by somatic mosaicism (HP:0001442): Description of conditions in which affected individuals typically display somatic mosaicism, i.e., genetically distinct populations of somatic cells in a given organism caused by DNA mutations, epigenetic alterations of DNA, chromosomal abnormalities or the spontaneous reversion of inherited mutations. In many conditions typified by somatic mosaicism, constitutive mutation is lethal and cases are exclusively or predominantly mosaic. Evidence: TAS. (OMIM:181030)
- Salivary gland neoplasm (HP:0100684): A tumor (abnormal growth of tissue) of a salivary gland. Evidence: TAS. (OMIM:181030)
- Autosomal dominant inheritance (HP:0000006): A mode of inheritance that is observed for traits related to a gene encoded on one of the autosomes (i.e., the human chromosomes 1-22) in which a trait manifests in heterozygotes. In the context of medical genetics, an autosomal dominant disorder is caused when a single copy of the mutant allele is present. Males and females are affected equally, and can both transmit the disorder with a risk of 50% for each child of inheriting the mutant allele. Evidence: TAS. (OMIM:181030)
These phenotypes are associated with the disease pleomorphic adenoma (OMIM:181030).